Phenotypes associated with the disease Cataract-intellectual disability-hypogonadism syndrome (ORPHA:1387):
- Hypogonadotropic hypogonadism (HP:0000044): Hypogonadotropic hypogonadism is characterized by reduced function of the gonads (testes in males or ovaries in females) and results from the absence of the gonadal stimulating pituitary hormones: follicle stimulating hormone (FSH) and luteinizing hormone (LH). Evidence: TAS. Frequency: Very frequent (HP:0040281). (ORPHA:1387)
- Furrowed tongue (HP:0000221): Accentuation of the grooves on the dorsal surface of the tongue. Evidence: TAS. Frequency: Very frequent (HP:0040281). (ORPHA:1387)
- Everted lower lip vermilion (HP:0000232): An abnormal configuration of the lower lip such that it is turned outward i.e., everted, with the Inner aspect of the lower lip vermilion (normally opposing the teeth) being visible in a frontal view. Evidence: TAS. Frequency: Very frequent (HP:0040281). (ORPHA:1387)
- Microcephaly (HP:0000252): Head circumference below 2 standard deviations below the mean for age and gender. Evidence: TAS. Frequency: Very frequent (HP:0040281). (ORPHA:1387)
- Malar flattening (HP:0000272): Underdevelopment of the malar prominence of the jugal bone (zygomatic bone in mammals), appreciated in profile, frontal view, and/or by palpation. Evidence: TAS. Frequency: Very frequent (HP:0040281). (ORPHA:1387)
- Short philtrum (HP:0000322): Distance between nasal base and midline upper lip vermilion border more than 2 SD below the mean. Alternatively, an apparently decreased distance between nasal base and midline upper lip vermilion border. Evidence: TAS. Frequency: Very frequent (HP:0040281). (ORPHA:1387)
- Cataract (HP:0000518): A cataract is an opacity or clouding that develops in the crystalline lens of the eye or in its capsule. Evidence: TAS. Frequency: Very frequent (HP:0040281). (ORPHA:1387)
- Intellectual disability (HP:0001249): The term intellectual disability or intellectual developmental disorder is used to describe significantly sub-average intellectual and adaptive functioning based on clinical assessment and as measured by individually administered, appropriately normed, standardized and validated tests of intellectual functioning and adaptive behavior, with onset during the developmental period from infancy through adolescence. Evidence: TAS. Frequency: Very frequent (HP:0040281). (ORPHA:1387)
- Low posterior hairline (HP:0002162): Hair on the neck extends more inferiorly than usual. Evidence: TAS. Frequency: Very frequent (HP:0040281). (ORPHA:1387)
- Short stature (HP:0004322): A height below that which is expected according to age and gender norms. Although there is no universally accepted definition of short stature, many refer to "short stature" as height more than 2 standard deviations below the mean for age and gender (or below the 3rd percentile for age and gender dependent norms). Evidence: TAS. Frequency: Very frequent (HP:0040281). (ORPHA:1387)
- Abnormal dermatoglyphics (HP:0007477): An abnormality of dermatoglyphs (fingerprints), which are present on fingers, palms, toes, and soles. Evidence: TAS. Frequency: Very frequent (HP:0040281). (ORPHA:1387)
- Prematurely aged appearance (HP:0007495). Evidence: TAS. Frequency: Very frequent (HP:0040281). (ORPHA:1387)
- Feeding difficulties in infancy (HP:0008872): Impaired feeding performance of an infant as manifested by difficulties such as weak and ineffective sucking, brief bursts of sucking, and falling asleep during sucking. There may be difficulties with chewing or maintaining attention. Evidence: TAS. Frequency: Very frequent (HP:0040281). (ORPHA:1387)
- Midface retrusion (HP:0011800): Posterior positions and/or vertical shortening of the infraorbital and perialar regions, or increased concavity of the face and/or reduced nasolabial angle. Evidence: TAS. Frequency: Very frequent (HP:0040281). (ORPHA:1387)
- Cryptorchidism (HP:0000028): Testis in inguinal canal. That is, absence of one or both testes from the scrotum owing to failure of the testis or testes to descend through the inguinal canal to the scrotum. Evidence: TAS. Frequency: Frequent (HP:0040282). (ORPHA:1387)
- High palate (HP:0000218): Height of the palate more than 2 SD above the mean (objective) or palatal height at the level of the first permanent molar more than twice the height of the teeth (subjective). Evidence: TAS. Frequency: Frequent (HP:0040282). (ORPHA:1387)
- Brachycephaly (HP:0000248): An abnormality of skull shape characterized by a decreased anterior-posterior diameter. That is, a cephalic index greater than 81%. Alternatively, an apparently shortened anteroposterior dimension (length) of the head compared to width. Evidence: TAS. Frequency: Frequent (HP:0040282). (ORPHA:1387)
- Micrognathia (HP:0000347): Developmental hypoplasia of the mandible. Evidence: TAS. Frequency: Frequent (HP:0040282). (ORPHA:1387)
- Hypotelorism (HP:0000601): Interpupillary distance less than 2 SD below the mean (alternatively, the appearance of an decreased interpupillary distance or closely spaced eyes). Evidence: TAS. Frequency: Frequent (HP:0040282). (ORPHA:1387)
- Tooth malposition (HP:0000692): Abnormal alignment, positioning, or spacing of the teeth, i.e., misaligned teeth. Evidence: TAS. Frequency: Frequent (HP:0040282). (ORPHA:1387)
- Abnormality of the hand (HP:0001155): An abnormality affecting one or both hands. Evidence: TAS. Frequency: Frequent (HP:0040282). (ORPHA:1387)
- Hyperlordosis (HP:0003307): Abnormally increased curvature (anterior concavity) of the lumbar or cervical spine. Evidence: TAS. Frequency: Frequent (HP:0040282). (ORPHA:1387)
- Depressed nasal bridge (HP:0005280): Posterior positioning of the nasal root in relation to the overall facial profile for age. Evidence: TAS. Frequency: Frequent (HP:0040282). (ORPHA:1387)
- Abnormal toenail morphology (HP:0008388): An anomaly of the toenail. Evidence: TAS. Frequency: Frequent (HP:0040282). (ORPHA:1387)
- Ulnar deviation of finger (HP:0009465): Bending or curvature of a finger toward the ulnar side (i.e., away from the thumb). The deviation is at the metacarpal-phalangeal joint, and this finding is distinct from clinodactyly. Evidence: TAS. Frequency: Frequent (HP:0040282). (ORPHA:1387)
- Abnormal distal phalanx morphology of finger (HP:0009832): Any anomaly of distal phalanx of finger. Evidence: TAS. Frequency: Frequent (HP:0040282). (ORPHA:1387)
- Cerebral cortical atrophy (HP:0002120): Atrophy of the cortex of the cerebrum. Evidence: TAS. Frequency: Occasional (HP:0040283). (ORPHA:1387)
- Scoliosis (HP:0002650): The presence of an abnormal lateral curvature of the spine. Evidence: TAS. Frequency: Occasional (HP:0040283). (ORPHA:1387)
- Abnormal antihelix morphology (HP:0009738): An abnormality of the antihelix. Evidence: TAS. Frequency: Occasional (HP:0040283). (ORPHA:1387)
- Posteriorly rotated ears (HP:0000358): A type of abnormal location of the ears in which the position of the ears is characterized by posterior rotation (the superior part of the ears is rotated towards the back of the head, and the inferior part of the ears towards the front). Evidence: TAS. Frequency: Frequent (HP:0040282). (ORPHA:1387)